- Hypertonia (HP:0001276): A condition in which there is increased muscle tone so that arms or legs, for example, are stiff and difficult to move. Evidence: IEA. (OMIM:610217)
- Progressive (HP:0003676): Applies to a disease manifestation that increases in scope or severity over the course of time, i.e., that worsens with age. Evidence: IEA. (OMIM:610217)
- Bradykinesia (HP:0002067): Bradykinesia literally means slow movement, and is used clinically to denote a slowness in the execution of movement (in contrast to hypokinesia, which is used to refer to slowness in the initiation of movement). Evidence: IEA. (OMIM:610217)
- Dysmetria (HP:0001310): A type of ataxia characterized by the inability to carry out movements with the correct range and motion across the plane of more than one joint related to incorrect estimation of the distances required for targeted movements. Evidence: IEA. (OMIM:610217)
- Dystonia (HP:0001332): An abnormally increased muscular tone that causes fixed abnormal postures. There is a slow, intermittent twisting motion that leads to exaggerated turning and posture of the extremities and trunk. Evidence: IEA. (OMIM:610217)
- Seizure (HP:0001250): A seizure is an intermittent abnormality of nervous system physiology characterized by a transient occurrence of signs and/or symptoms due to abnormal excessive or synchronous neuronal activity in the brain. Evidence: IEA. (OMIM:610217)
- Cerebellar atrophy (HP:0001272): Cerebellar atrophy is defined as a cerebellum with initially normal structures, in a posterior fossa with normal size, which displays enlarged fissures (interfolial spaces) in comparison to the foliae secondary to loss of tissue. Cerebellar atrophy implies irreversible loss of tissue and result from an ongoing progressive disease until a final stage is reached or a single injury, e.g. an intoxication or infectious event. Evidence: IEA. (OMIM:610217)
- Gait ataxia (HP:0002066): A type of ataxia characterized by the impairment of the ability to coordinate the movements required for normal walking. Gait ataxia is characteirzed by a wide-based staggering gait with a tendency to fall. Evidence: IEA. (OMIM:610217)
- Neurofibrillary tangles (HP:0002185): Pathological protein aggregates formed by hyperphosphorylation of a microtubule-associated protein known as tau, causing it to aggregate in an insoluble form. Evidence: IEA. (OMIM:610217)
- Neurodegeneration (HP:0002180): Progressive loss of neural cells and tissue. Evidence: TAS. (OMIM:610217)
- Intention tremor (HP:0002080): A type of kinetic tremor that occurs during target directed movement is called intention tremor. That is, an oscillatory cerebellar ataxia that tends to be absent when the limbs are inactive and during the first part of voluntary movement but worsening as the movement continues and greater precision is required (e.g., in touching a target such as the patient's nose or a physician's finger). Evidence: IEA. (OMIM:610217)
- Nystagmus (HP:0000639): Rhythmic, involuntary oscillations of one or both eyes related to abnormality in fixation, conjugate gaze, or vestibular mechanisms. Evidence: IEA. (OMIM:610217)
- Childhood onset (HP:0011463): Onset of disease at the age of between 1 and 5 years. Evidence: TAS. (OMIM:610217)
- Emotional lability (HP:0000712): Unstable emotional experiences and frequent mood changes; emotions that are easily aroused, intense, and/or disproportionate to events and circumstances. Evidence: IEA. (OMIM:610217)
- Short attention span (HP:0000736): Reduced attention span characterized by distractibility and impulsivity. Evidence: IEA. (OMIM:610217)
- Hyperactivity (HP:0000752): Hyperactivity is a condition characterized by constant and unusually high levels of activity, even in situations where it is deemed inappropriate. Evidence: IEA. (OMIM:610217)
- Mental deterioration (HP:0001268): Loss of previously present mental abilities, generally in adults. Evidence: IEA. (OMIM:610217)
- Talipes calcaneovalgus (HP:0001884): Talipes calcaneovalgus is a flexible foot deformity (as opposed to a rigid congenital vertical talus foot deformity) that can either present as a positional or structural foot deformity depending on severity and/or causality. The axis of calcaneovalgus deformity is in the tibiotalar joint, where the foot is positioned in extreme hyperextension. On inspection, the foot has an "up and out" appearance, with the dorsal forefoot practically touching the anterior aspect of the ankle and lower leg. Evidence: IEA. (OMIM:610217)
- Dysphagia (HP:0002015): Difficulty in swallowing. Evidence: IEA. (OMIM:610217)
- Cerebral atrophy (HP:0002059): Atrophy (wasting, decrease in size of cells or tissue) affecting the cerebrum. Evidence: IEA. (OMIM:610217)
- Delayed speech and language development (HP:0000750): A degree of language development that is significantly below the norm for a child of a specified age. Evidence: IEA. (OMIM:610217)
- Babinski sign (HP:0003487): Upturning of the big toe (and sometimes fanning of the other toes) in response to stimulation of the sole of the foot. If the Babinski sign is present it can indicate damage to the corticospinal tract. Evidence: IEA. (OMIM:610217)
- Feeding difficulties (HP:0011968): Impaired ability to eat related to problems gathering food and getting ready to suck, chew, or swallow it. Evidence: TAS. (OMIM:610217)
- Dysarthria (HP:0001260): Dysarthric speech is a general description referring to a neurological speech disorder characterized by poor articulation. Depending on the involved neurological structures, dysarthria may be further classified as spastic, flaccid, ataxic, hyperkinetic and hypokinetic, or mixed. Evidence: IEA. (OMIM:610217)
- Dysdiadochokinesis (HP:0002075): A type of ataxia characterized by the impairment of the ability to perform rapidly alternating movements, such as pronating and supinating his or her hand on the dorsum of the other hand as rapidly as possible. Evidence: IEA. (OMIM:610217)
- Chorea (HP:0002072): Chorea (Greek for 'dance') refers to widespread arrhythmic involuntary movements of a forcible, jerky and restless fashion. It is a random-appearing sequence of one or more discrete involuntary movements or movement fragments. Movements appear random because of variability in timing, duration or location. Each movement may have a distinct start and end. However, movements may be strung together and thus may appear to flow randomly from one muscle group to another. Chorea can involve the trunk, neck, face, tongue, and extremities. Evidence: IEA. (OMIM:610217)
- Impulsivity (HP:0100710): Acting on the spur of the moment or on a momentary basis without consideration of outcomes; having difficulty establishing or following plans; experiencing a sense of urgency and engaging in behavior that is uninhibited, cannot be inhibited, and is uncontrolled. The possibility of repression is inconceivable. Evidence: TAS. (OMIM:610217)
- Lewy bodies (HP:0100315). Evidence: IEA. (OMIM:610217)
- Impaired smooth pursuit (HP:0007772): An impairment of the ability to track objects with the ocular smooth pursuit system, a class of rather slow eye movements that minimizes retinal target motion. Evidence: IEA. (OMIM:610217)
- Autosomal recessive inheritance (HP:0000007): A mode of inheritance that is observed for traits related to a gene encoded on one of the autosomes (i.e., the human chromosomes 1-22) in which a trait manifests in individuals with two pathogenic alleles, either homozygotes (two copies of the same mutant allele) or compound heterozygotes (whereby each copy of a gene has a distinct mutant allele). Evidence: IEA. (OMIM:610217)
- Optic atrophy (HP:0000648): Atrophy of the optic nerve. Optic atrophy results from the death of the retinal ganglion cell axons that comprise the optic nerve and manifesting as a pale optic nerve on fundoscopy. Evidence: IEA. (OMIM:610217)
- Spasticity (HP:0001257): A motor disorder characterized by a velocity-dependent increase in tonic stretch reflexes with increased muscle tone, exaggerated (hyperexcitable) tendon reflexes. Evidence: TAS. (OMIM:610217)
These phenotypes are associated with the disease neurodegeneration with brain iron accumulation 2B (OMIM:610217).